Phenotypes associated with the disease ophthalmoplegia-intellectual disability-lingua scrotalis syndrome (OMIM:165150):
- Furrowed tongue (HP:0000221): Accentuation of the grooves on the dorsal surface of the tongue. Evidence: IEA. (OMIM:165150)
- Progressive ophthalmoplegia (HP:0007650). Evidence: IEA. (OMIM:165150)
- Autosomal dominant inheritance (HP:0000006): A mode of inheritance that is observed for traits related to a gene encoded on one of the autosomes (i.e., the human chromosomes 1-22) in which a trait manifests in heterozygotes. In the context of medical genetics, an autosomal dominant disorder is caused when a single copy of the mutant allele is present. Males and females are affected equally, and can both transmit the disorder with a risk of 50% for each child of inheriting the mutant allele. Evidence: IEA. (OMIM:165150)
- Intellectual disability (HP:0001249): The term intellectual disability or intellectual developmental disorder is used to describe significantly sub-average intellectual and adaptive functioning based on clinical assessment and as measured by individually administered, appropriately normed, standardized and validated tests of intellectual functioning and adaptive behavior, with onset during the developmental period from infancy through adolescence. Evidence: IEA. (OMIM:165150)